Phenotypes associated with the disease Idiopathic neonatal atrial flutter (ORPHA:45452):
- Abnormal EKG (HP:0003115): Abnormal rhythm of the heart. Evidence: TAS. Frequency: Very frequent (HP:0040281). (ORPHA:45452)
- Supraventricular tachycardia (HP:0004755): Supraventricular tachycardia (SVT) is an abnormally increased heart rate (over 100 beats per minute at rest) with origin above the level of the ventricles. Evidence: TAS. Frequency: Very frequent (HP:0040281). (ORPHA:45452)
- Abnormal atrioventricular conduction (HP:0005150): An impairment of the electrical continuity between the atria and ventricles. Evidence: TAS. Frequency: Very frequent (HP:0040281). (ORPHA:45452)
- Arrhythmia (HP:0011675): Any cardiac rhythm other than the normal sinus rhythm. Such a rhythm may be either of sinus or ectopic origin and either regular or irregular. An arrhythmia may be due to a disturbance in impulse formation or conduction or both. Evidence: TAS. Frequency: Very frequent (HP:0040281). (ORPHA:45452)
- Tachypnea (HP:0002789): Very rapid breathing. Evidence: TAS. Frequency: Frequent (HP:0040282). (ORPHA:45452)
- Paroxysmal supraventricular tachycardia (HP:0004763): An episodic form of supraventricular tachycardia with abrupt onset and termination. Evidence: TAS. Frequency: Frequent (HP:0040282). (ORPHA:45452)
- Abnormal left ventricular function (HP:0005162): Inability of the left ventricle to perform its normal physiologic function. Failure is either due to an inability to contract the left ventricle or the inability to relax completely and fill with blood during diastole. Evidence: TAS. Frequency: Frequent (HP:0040282). (ORPHA:45452)
- Reduced left ventricular ejection fraction (HP:0012664): A diminution of the volumetric fraction of blood pumped out of the ventricle with each cardiac cycle. Evidence: TAS. Frequency: Frequent (HP:0040282). (ORPHA:45452)
- Abnormal QRS complex (HP:0025074): An anomaly of the complex formed by the Q, R, and S waves, which occur in rapid succession on the electrocardiogram. Evidence: TAS. Frequency: Frequent (HP:0040282). (ORPHA:45452)
- Large for gestational age (HP:0001520): The term large for gestational age applies to babies whose birth weight lies above the 90th percentile for that gestational age. Evidence: TAS. Frequency: Occasional (HP:0040283). (ORPHA:45452)
- Hydrops fetalis (HP:0001789): The abnormal accumulation of fluid in two or more fetal compartments, including ascites, pleural effusion, pericardial effusion, and skin edema. Evidence: TAS. Frequency: Occasional (HP:0040283). (ORPHA:45452)
- Respiratory distress (HP:0002098): Respiratory distress is objectively observable as the physical or emotional consequences from the experience of dyspnea. The physical presentation of respiratory distress is generally referred to as labored breathing, while the sensation of respiratory distress is called shortness of breath or dyspnea. Evidence: TAS. Frequency: Occasional (HP:0040283). (ORPHA:45452)
- Feeding difficulties in infancy (HP:0008872): Impaired feeding performance of an infant as manifested by difficulties such as weak and ineffective sucking, brief bursts of sucking, and falling asleep during sucking. There may be difficulties with chewing or maintaining attention. Evidence: TAS. Frequency: Occasional (HP:0040283). (ORPHA:45452)
- Maternal diabetes (HP:0009800): Maternal diabetes can either be a gestational, mostly type 2 diabetes, or a type 1 diabetes. Essential is the resulting maternal hyperglycemia as a non-specific teratogen, imposing the same risk of congenital malformations to pregnant women with both type 1 and type2 diabetes. Evidence: TAS. Frequency: Occasional (HP:0040283). (ORPHA:45452)
- Fetal distress (HP:0025116): An intrauterine state characterized by suboptimal values in the fetal heart rate, oxygenation of fetal blood, or other parameters indicative of compromise of the fetus. Signs of fetal distress include repetitive variable decelerations, fetal tachycardia or bradycardia, late decelerations, or low biophysical profile. Evidence: TAS. Frequency: Occasional (HP:0040283). (ORPHA:45452)